- Cyanosis (HP:0000961): Bluish discoloration of the skin and mucosa due to poor circulation or inadequate oxygenation of arterial or capillary blood. Evidence: TAS. Frequency: Frequent (HP:0040282). (ORPHA:555874)
- Intrauterine growth retardation (HP:0001511): An abnormal restriction of fetal growth with fetal weight below the tenth percentile for gestational age. Evidence: TAS. Frequency: Frequent (HP:0040282). (ORPHA:555874)
- Small for gestational age (HP:0001518): Smaller than normal size according to sex and gestational age related norms, defined as a weight below the 10th percentile for the gestational age. Evidence: TAS. Frequency: Frequent (HP:0040282). (ORPHA:555874)
- Premature birth (HP:0001622): The birth of a baby of less than 37 weeks of gestational age. Evidence: TAS. Frequency: Frequent (HP:0040282). (ORPHA:555874)
- Cardiomegaly (HP:0001640): Increased size of the heart, clinically defined as an increased transverse diameter of the cardiac silhouette that is greater than or equal to 50% of the transverse diameter of the chest (increased cardiothoracic ratio) on a posterior-anterior projection of a chest radiograph or a computed tomography. Evidence: TAS. Frequency: Frequent (HP:0040282). (ORPHA:555874)
- Right ventricular hypertrophy (HP:0001667): In this case the right ventricle is more muscular than normal, causing a characteristic boot-shaped (coeur-en-sabot) appearance as seen on anterior- posterior chest x-rays. Right ventricular hypertrophy is commonly associated with any form of right ventricular outflow obstruction or pulmonary hypertension, which may in turn owe its origin to left-sided disease. The echocardiographic signs are thickening of the anterior right ventricular wall and the septum. Cavity size is usually normal, or slightly enlarged. In many cases there is associated volume overload present due to tricuspid regurgitation, in the absence of this, septal motion is normal. Evidence: TAS. Frequency: Frequent (HP:0040282). (ORPHA:555874)
- Hepatomegaly (HP:0002240): Abnormally increased size of the liver. Evidence: TAS. Frequency: Frequent (HP:0040282). (ORPHA:555874)
- Tachypnea (HP:0002789): Very rapid breathing. Evidence: TAS. Frequency: Frequent (HP:0040282). (ORPHA:555874)
- Respiratory failure (HP:0002878): A severe form of respiratory insufficiency characterized by inadequate gas exchange such that the levels of oxygen or carbon dioxide cannot be maintained within normal limits. Evidence: TAS. Frequency: Frequent (HP:0040282). (ORPHA:555874)
- Respiratory failure requiring assisted ventilation (HP:0004887): A state of respiratory distress that requires a life saving intervention in the form of gaining airway access and instituting positive pressure ventilation. Evidence: TAS. Frequency: Frequent (HP:0040282). (ORPHA:555874)
- Tricuspid regurgitation (HP:0005180): Failure of the tricuspid valve to close sufficiently upon contraction of the right ventricle, causing blood to regurgitate (flow backward) into the right atrium. Evidence: TAS. Frequency: Frequent (HP:0040282). (ORPHA:555874)
- Anomalous pulmonary venous return (HP:0010772): A developmental defect characterized by abnormal connection of one or more pulmonary veins to the superior or inferior vena cava, the right atrium, or the coronary sinus, resulting in a left-to-right shunt of oxygenated blood. Evidence: TAS. Frequency: Frequent (HP:0040282). (ORPHA:555874)
- Hypoxemia (HP:0012418): An abnormally low level of blood oxygen. Evidence: TAS. Frequency: Frequent (HP:0040282). (ORPHA:555874)
- Abnormal tricuspid valve annulus morphology (HP:0031441): Any structural anomaly of the annulus of the tricuspid valve. The annulus is a ring composed of fibrous and myocardial tissue and is the structure onto which the cusps of the valve attach. Evidence: TAS. Frequency: Frequent (HP:0040282). (ORPHA:555874)
- Abnormal tricuspid valve leaflet morphology (HP:0031443): Any structural anomaly of the leaflets (also known as cusps) of the tricuspid valve. Evidence: TAS. Frequency: Frequent (HP:0040282). (ORPHA:555874)
- Systolic heart murmur (HP:0031664): A heart murmur limited to systole, i.e., between the first and second heart sounds S1 and S2. Evidence: TAS. Frequency: Frequent (HP:0040282). (ORPHA:555874)
- Patent foramen ovale (HP:0001655): Failure of the foramen ovale to seal postnatally, leaving a potential conduit between the left and right cardiac atria. Evidence: TAS. Frequency: Occasional (HP:0040283). (ORPHA:555874)
- Pericardial effusion (HP:0001698): Accumulation of fluid within the pericardium. Evidence: TAS. Frequency: Occasional (HP:0040283). (ORPHA:555874)
- Tricuspid valve prolapse (HP:0001704): One or more of the leaflets (cusps) of the tricuspid valve bulges back into the right atrium upon contraction of the right ventricle. Evidence: TAS. Frequency: Occasional (HP:0040283). (ORPHA:555874)
- Right atrial enlargement (HP:0030718): Increase in size of the right atrium. Evidence: TAS. Frequency: Occasional (HP:0040283). (ORPHA:555874)
These phenotypes are associated with the disease Congenital tricuspid valve dysplasia (ORPHA:555874).